Phenotypes associated with the disease Hereditary continuous muscle fiber activity (ORPHA:972):
- Congenital diaphragmatic hernia (HP:0000776): The presence of a hernia of the diaphragm present at birth. Evidence: TAS. Frequency: Occasional (HP:0040283). (ORPHA:972)
- Seizure (HP:0001250): A seizure is an intermittent abnormality of nervous system physiology characterized by a transient occurrence of signs and/or symptoms due to abnormal excessive or synchronous neuronal activity in the brain. Evidence: TAS. Frequency: Occasional (HP:0040283). (ORPHA:972)
- Ataxia (HP:0001251): Ataxia refers to impaired coordination of voluntary muscle movement. Cerebellar ataxia refers to ataxia due to dysfunction of the cerebellum. This causes a variety of elementary neurological deficits including asynergy (lack of coordination between muscles, limbs and joints), dysmetria (lack of ability to judge distances that can lead to under- or overshoot in grasping movements), and dysdiadochokinesia (inability to perform rapid movements requiring antagonizing muscle groups to be switched on and off repeatedly). Evidence: TAS. Frequency: Frequent (HP:0040282). (ORPHA:972)
- Dysarthria (HP:0001260): Dysarthric speech is a general description referring to a neurological speech disorder characterized by poor articulation. Depending on the involved neurological structures, dysarthria may be further classified as spastic, flaccid, ataxic, hyperkinetic and hypokinetic, or mixed. Evidence: TAS. Frequency: Frequent (HP:0040282). (ORPHA:972)
- Slurred speech (HP:0001350): Abnormal coordination of muscles involved in speech. Evidence: TAS. Frequency: Frequent (HP:0040282). (ORPHA:972)
- Spastic gait (HP:0002064): Spasticity is manifested by increased stretch reflex which is intensified with movement velocity. This results in excessive and inappropriate muscle activation which can contribute to muscle hypertonia. Spastic gait is characterized by manifestations such as muscle hypertonia, stiff knee, and circumduction of the leg. Evidence: TAS. Frequency: Very frequent (HP:0040281). (ORPHA:972)
- Elevated circulating creatine kinase activity (HP:0003236): The activity of creatine kinase in the blood circulation is above the upper limit of normal. Evidence: TAS. Frequency: Very frequent (HP:0040281). (ORPHA:972)
- EMG abnormality (HP:0003457): Abnormal results of investigations using electromyography (EMG). Evidence: TAS. Frequency: Very frequent (HP:0040281). (ORPHA:972)
- Type 1 muscle fiber predominance (HP:0003803): An abnormal predominance of type I muscle fibers (in general, this feature can only be observed on muscle biopsy). Evidence: TAS. Frequency: Very frequent (HP:0040281). (ORPHA:972)
- Abnormality of movement (HP:0100022): An abnormality of movement with a neurological basis characterized by changes in coordination and speed of voluntary movements. Evidence: TAS. Frequency: Very frequent (HP:0040281). (ORPHA:972)